- Renal agenesis (HP:0000104): Agenesis, that is, failure of the kidney to develop during embryogenesis and development. Evidence: TAS. Frequency: Very frequent (HP:0040281). (ORPHA:1848)
- Epicanthus (HP:0000286): A fold of skin starting above the medial aspect of the upper eyelid and arching downward to cover, pass in front of and lateral to the medial canthus. Evidence: TAS. Frequency: Very frequent (HP:0040281). (ORPHA:1848)
- Hypertelorism (HP:0000316): Interpupillary distance more than 2 SD above the mean (alternatively, the appearance of an increased interpupillary distance or widely spaced eyes). Evidence: TAS. Frequency: Very frequent (HP:0040281). (ORPHA:1848)
- Low-set ears (HP:0000369): Upper insertion of the ear to the scalp below an imaginary horizontal line drawn between the inner canthi of the eye and extending posteriorly to the ear. Evidence: TAS. Frequency: Very frequent (HP:0040281). (ORPHA:1848)
- Depressed nasal ridge (HP:0000457): Lack of prominence of the nose resulting from a posteriorly-placed nasal ridge. Evidence: TAS. Frequency: Very frequent (HP:0040281). (ORPHA:1848)
- Oligohydramnios (HP:0001562): Diminished amniotic fluid volume in pregnancy. Evidence: TAS. Frequency: Very frequent (HP:0040281). (ORPHA:1848)
- Nonketotic hypoglycemia (HP:0001958). Evidence: TAS. Frequency: Very frequent (HP:0040281). (ORPHA:1848)
- Pulmonary hypoplasia (HP:0002089). Evidence: TAS. Frequency: Very frequent (HP:0040281). (ORPHA:1848)
- Fetal polyuria (HP:0001563): Abnormally increased production of urine by the fetus resulting in polyhydramnios. Evidence: TAS. Frequency: Frequent (HP:0040282). (ORPHA:1848)
- Abnormal intestine morphology (HP:0002242): An abnormality of the intestine. The closely related term enteropathy is used to refer to any disease of the intestine. Evidence: TAS. Frequency: Frequent (HP:0040282). (ORPHA:1848)
- Tracheoesophageal fistula (HP:0002575): An abnormal connection (fistula) between the esophagus and the trachea. Evidence: TAS. Frequency: Frequent (HP:0040282). (ORPHA:1848)
- Abnormal sacrum morphology (HP:0005107): An abnormality of the sacral bone. Evidence: TAS. Frequency: Frequent (HP:0040282). (ORPHA:1848)
- Abnormal cardiovascular system morphology (HP:0030680): Any structural anomaly of the heart and blood vessels. Evidence: TAS. Frequency: Frequent (HP:0040282). (ORPHA:1848)
- Urogenital fistula (HP:0100589): The presence of a fistula affecting the genitourinary system. Evidence: TAS. Frequency: Frequent (HP:0040282). (ORPHA:1848)
- Abnormal morphology of female internal genitalia (HP:0000008): An abnormality of the female internal genitalia. Evidence: TAS. Frequency: Occasional (HP:0040283). (ORPHA:1848)
- Cleft palate (HP:0000175): Cleft palate is a developmental defect of the palate resulting from a failure of fusion of the palatine processes and manifesting as a separation of the roof of the mouth (soft and hard palate). Evidence: TAS. Frequency: Occasional (HP:0040283). (ORPHA:1848)
- Sirenomelia (HP:0010497): A developmental defect in which the legs are fused together. Evidence: TAS. Frequency: Occasional (HP:0040283). (ORPHA:1848)
- Non-midline cleft of the upper lip (HP:0100335): Clefting (gap or groove) of the upper lip affecting the lateral portions of the upper lip rather than the midline/median region. Evidence: TAS. Frequency: Occasional (HP:0040283). (ORPHA:1848)
These phenotypes are associated with the disease Renal agenesis, bilateral (ORPHA:1848).